- Ataxia (HP:0001251): Ataxia refers to impaired coordination of voluntary muscle movement. Cerebellar ataxia refers to ataxia due to dysfunction of the cerebellum. This causes a variety of elementary neurological deficits including asynergy (lack of coordination between muscles, limbs and joints), dysmetria (lack of ability to judge distances that can lead to under- or overshoot in grasping movements), and dysdiadochokinesia (inability to perform rapid movements requiring antagonizing muscle groups to be switched on and off repeatedly). Evidence: IEA. (OMIM:108700)
- Fasciculations (HP:0002380): Fasciculations are observed as small, local, involuntary muscle contractions (twitching) visible under the skin. Fasciculations result from increased irritability of an axon (which in turn is often a manifestation of disease of a motor neuron). This leads to sporadic discharges of all the muscle fibers controlled by the axon in isolation from other motor units. Evidence: IEA. (OMIM:108700)
- Autosomal dominant inheritance (HP:0000006): A mode of inheritance that is observed for traits related to a gene encoded on one of the autosomes (i.e., the human chromosomes 1-22) in which a trait manifests in heterozygotes. In the context of medical genetics, an autosomal dominant disorder is caused when a single copy of the mutant allele is present. Males and females are affected equally, and can both transmit the disorder with a risk of 50% for each child of inheriting the mutant allele. Evidence: IEA. (OMIM:108700)
These phenotypes are associated with the disease ataxia with fasciculations (OMIM:108700).